- Global developmental delay (HP:0001263): A delay in the achievement of motor or mental milestones in the domains of development of a child, including motor skills, speech and language, cognitive skills, and social and emotional skills. This term should only be used to describe children younger than five years of age. Evidence: TAS. Frequency: Very frequent (HP:0040281). (ORPHA:314679)
- Abnormal facial shape (HP:0001999): An abnormal morphology (form) of the face or its components. Evidence: TAS. Frequency: Very frequent (HP:0040281). (ORPHA:314679)
- Microtia (HP:0008551): Underdevelopment of the external ear. Evidence: TAS. Frequency: Very frequent (HP:0040281). (ORPHA:314679)
- Feeding difficulties in infancy (HP:0008872): Impaired feeding performance of an infant as manifested by difficulties such as weak and ineffective sucking, brief bursts of sucking, and falling asleep during sucking. There may be difficulties with chewing or maintaining attention. Evidence: TAS. Frequency: Very frequent (HP:0040281). (ORPHA:314679)
- Floppy infant (HP:0008947): Floppiness/hypotonia is defined as reduced resistance to passive movement of joints. Physical examination of floppy/hypotonic infants shows head lag, lack of shoulder and elbow muscle contraction on traction response, inability to tighten the shoulder girdle muscles (or slipping through) when held under the axillae, scarf sign (when the arm is pulled to the opposite side, the arm wraps around the neck with the elbow crossing midline), hyperdorsiflexion of the feet, easy apposition of the thumb against the forearm, feet touching the cheek with ease and without discomfort, frog leg position, and inverted U sign on ventral suspension (head, arms, and legs hanging down without elbow or knee flexion and the trunk rounded in a dome shape). Evidence: TAS. Frequency: Very frequent (HP:0040281). (ORPHA:314679)
- Camptodactyly (HP:0012385): The distal interphalangeal joint and/or the proximal interphalangeal joint of the fingers or toes cannot be extended to 180 degrees by either active or passive extension. Evidence: TAS. Frequency: Very frequent (HP:0040281). (ORPHA:314679)
- Renal hypoplasia (HP:0000089): Hypoplasia of the kidney. Evidence: TAS. Frequency: Frequent (HP:0040282). (ORPHA:314679)
- Large fontanelles (HP:0000239): In newborns, the two frontal bones, two parietal bones, and one occipital bone are joined by fibrous sutures, which form a small posterior fontanelle, and a larger, diamond-shaped anterior fontanelle. These regions allow for the skull to pass the birth canal and for later growth. The fontanelles gradually ossify, whereby the posterior fontanelle usually closes by eight weeks and the anterior fontanelle by the 9th to 16th month of age. Large fontanelles are diagnosed if the fontanelles are larger than age-dependent norms. Evidence: TAS. Frequency: Frequent (HP:0040282). (ORPHA:314679)
- Micrognathia (HP:0000347): Developmental hypoplasia of the mandible. Evidence: TAS. Frequency: Frequent (HP:0040282). (ORPHA:314679)
- Conductive hearing impairment (HP:0000405): An abnormality of vibrational conductance of sound to the inner ear leading to impairment of sensory perception of sound. Evidence: TAS. Frequency: Frequent (HP:0040282). (ORPHA:314679)
- Osteopenia (HP:0000938): Osteopenia is a term to define bone density that is not normal but also not as low as osteoporosis. By definition from the World Health Organization osteopenia is defined by bone densitometry as a T score -1 to -2.5. Evidence: TAS. Frequency: Frequent (HP:0040282). (ORPHA:314679)
- Syndactyly (HP:0001159): Webbing or fusion of the fingers or toes, involving soft parts only or including bone structure. Bony fusions are referred to as "bony" syndactyly if the fusion occurs in a radio-ulnar axis. Fusions of bones of the fingers or toes in a proximo-distal axis are referred to as "symphalangism". Evidence: TAS. Frequency: Frequent (HP:0040282). (ORPHA:314679)
- Moderate intellectual disability (HP:0002342): Moderate intellectual disability (ID) is defined as a type of ID characterized by moderately sub-average adaptive functioning and intellectual functioning, with an intelligence quotient (IQ) the range of 35-49. Evidence: TAS. Frequency: Frequent (HP:0040282). (ORPHA:314679)
- Abnormal tracheal morphology (HP:0002778): A structural anomaly of the trachea. Evidence: TAS. Frequency: Frequent (HP:0040282). (ORPHA:314679)
- Gastrostomy tube feeding in infancy (HP:0011471): Feeding problem necessitating gastrostomy tube feeding. Evidence: TAS. Frequency: Frequent (HP:0040282). (ORPHA:314679)
- Hypospadias (HP:0000047): Abnormal position of urethral meatus on the ventral penile shaft (underside) characterized by displacement of the urethral meatus from the tip of the glans penis to the ventral surface of the penis, scrotum, or perineum. Evidence: TAS. Frequency: Occasional (HP:0040283). (ORPHA:314679)
- Narrow mouth (HP:0000160): Distance between the commissures of the mouth more than 2 SD below the mean. Alternatively, an apparently decreased width of the oral aperture (subjective). Evidence: TAS. Frequency: Occasional (HP:0040283). (ORPHA:314679)
- Microcephaly (HP:0000252): Head circumference below 2 standard deviations below the mean for age and gender. Evidence: TAS. Frequency: Occasional (HP:0040283). (ORPHA:314679)
- Epicanthus (HP:0000286): A fold of skin starting above the medial aspect of the upper eyelid and arching downward to cover, pass in front of and lateral to the medial canthus. Evidence: TAS. Frequency: Occasional (HP:0040283). (ORPHA:314679)
- Hypertelorism (HP:0000316): Interpupillary distance more than 2 SD above the mean (alternatively, the appearance of an increased interpupillary distance or widely spaced eyes). Evidence: TAS. Frequency: Occasional (HP:0040283). (ORPHA:314679)
- Hypoplasia of the maxilla (HP:0000327): Abnormally small dimension of the Maxilla. Usually creating a malocclusion or malalignment between the upper and lower teeth or resulting in a deficient amount of projection of the base of the nose and lower midface region. Evidence: TAS. Frequency: Occasional (HP:0040283). (ORPHA:314679)
- Wide nasal bridge (HP:0000431): Increased breadth of the nasal bridge (and with it, the nasal root). Evidence: TAS. Frequency: Occasional (HP:0040283). (ORPHA:314679)
- Blepharophimosis (HP:0000581): A fixed reduction in the vertical distance between the upper and lower eyelids with short palpebral fissures. Evidence: TAS. Frequency: Occasional (HP:0040283). (ORPHA:314679)
- Lymphedema (HP:0001004): Localized fluid retention and tissue swelling caused by a compromised lymphatic system. Evidence: TAS. Frequency: Occasional (HP:0040283). (ORPHA:314679)
- Ataxia (HP:0001251): Ataxia refers to impaired coordination of voluntary muscle movement. Cerebellar ataxia refers to ataxia due to dysfunction of the cerebellum. This causes a variety of elementary neurological deficits including asynergy (lack of coordination between muscles, limbs and joints), dysmetria (lack of ability to judge distances that can lead to under- or overshoot in grasping movements), and dysdiadochokinesia (inability to perform rapid movements requiring antagonizing muscle groups to be switched on and off repeatedly). Evidence: TAS. Frequency: Occasional (HP:0040283). (ORPHA:314679)
- Agenesis of corpus callosum (HP:0001274): Absence of the corpus callosum as a result of the failure of the corpus callosum to develop, which can be the result of a failure in any one of the multiple steps of callosal development including cellular proliferation and migration, axonal growth or glial patterning at the midline. Evidence: TAS. Frequency: Occasional (HP:0040283). (ORPHA:314679)
- Cerebellar vermis hypoplasia (HP:0001320): Underdevelopment of the vermis of cerebellum. Evidence: TAS. Frequency: Occasional (HP:0040283). (ORPHA:314679)
- Anteriorly placed anus (HP:0001545): Anterior malposition of the anus. Evidence: TAS. Frequency: Occasional (HP:0040283). (ORPHA:314679)
- Abnormal heart morphology (HP:0001627): Any structural anomaly of the heart. Evidence: TAS. Frequency: Occasional (HP:0040283). (ORPHA:314679)
- Pulmonic stenosis (HP:0001642): A narrowing of the right ventricular outflow tract that can occur at the pulmonary valve (valvular stenosis), below the pulmonary valve (infundibular stenosis), or above the pulmonary valve (supravalvar stenosis). Evidence: TAS. Frequency: Occasional (HP:0040283). (ORPHA:314679)
- Talipes equinovarus (HP:0001762): Talipes equinovarus (also called clubfoot) typically has four main components: inversion and adduction of the forefoot; inversion of the heel and hindfoot; equinus (limitation of extension) of the ankle and subtalar joint; and internal rotation of the leg. Evidence: TAS. Frequency: Occasional (HP:0040283). (ORPHA:314679)
- Anal stenosis (HP:0002025): Abnormal narrowing of the anal opening. Evidence: TAS. Frequency: Occasional (HP:0040283). (ORPHA:314679)
- Hypoplasia of the corpus callosum (HP:0002079): Underdevelopment of the corpus callosum. Evidence: TAS. Frequency: Occasional (HP:0040283). (ORPHA:314679)
- Ventriculomegaly (HP:0002119): An increase in size of the ventricular system of the brain. Evidence: TAS. Frequency: Occasional (HP:0040283). (ORPHA:314679)
- Gray matter heterotopia (HP:0002282): Heterotopia or neuronal heterotopia are macroscopic clusters of misplaced neurons (gray matter), most often situated along the ventricular walls or within the subcortical white matter. Evidence: TAS. Frequency: Occasional (HP:0040283). (ORPHA:314679)
- Tracheomalacia (HP:0002779). Evidence: TAS. Frequency: Occasional (HP:0040283). (ORPHA:314679)
- Caudal appendage (HP:0002825): The presence of a tail-like skin appendage located adjacent to the sacrum. Evidence: TAS. Frequency: Occasional (HP:0040283). (ORPHA:314679)
- Short stature (HP:0004322): A height below that which is expected according to age and gender norms. Although there is no universally accepted definition of short stature, many refer to "short stature" as height more than 2 standard deviations below the mean for age and gender (or below the 3rd percentile for age and gender dependent norms). Evidence: TAS. Frequency: Occasional (HP:0040283). (ORPHA:314679)
- Dysplastic corpus callosum (HP:0006989): Dysplasia and dysgenesis of the corpus callosum are nonspecific descriptions that imply defective development of the corpus callosum. The term dysplasia is applied when the morphology of the corpus callosum is altered as a congenital trait. For instance, the corpus callosum may be hump-shaped, kinked, or a striped corpus callosum that lacks an anatomically distinct genu and splenium. Evidence: TAS. Frequency: Occasional (HP:0040283). (ORPHA:314679)
- Absence of pubertal development (HP:0008197). Evidence: TAS. Frequency: Occasional (HP:0040283). (ORPHA:314679)
- Severe intellectual disability (HP:0010864): Severe intellectual disability (ID) is defined as a type of ID characterized by severely sub-average adaptive functioning and intellectual functioning, with an intelligence quotient (IQ) the range of 20-34. Evidence: TAS. Frequency: Occasional (HP:0040283). (ORPHA:314679)
- Irregular dentition (HP:0040079). Evidence: TAS. Frequency: Occasional (HP:0040283). (ORPHA:314679)
- Self-injurious behavior (HP:0100716): Self-aggression. Evidence: TAS. Frequency: Occasional (HP:0040283). (ORPHA:314679)
- Bilateral choanal atresia/stenosis (HP:0200138). Evidence: TAS. Frequency: Occasional (HP:0040283). (ORPHA:314679)
These phenotypes are associated with the disease Cerebrofacioarticular syndrome (ORPHA:314679).